Phenotypes associated with the disease popliteal cyst (OMIM:175750):
- Joint swelling (HP:0001386). Evidence: PCS. (PMID:5080689)
- Abnormality of the knee (HP:0002815): An abnormality of the knee joint or surrounding structures. Evidence: IEA. (OMIM:175750)
- Autosomal dominant inheritance (HP:0000006): A mode of inheritance that is observed for traits related to a gene encoded on one of the autosomes (i.e., the human chromosomes 1-22) in which a trait manifests in heterozygotes. In the context of medical genetics, an autosomal dominant disorder is caused when a single copy of the mutant allele is present. Males and females are affected equally, and can both transmit the disorder with a risk of 50% for each child of inheriting the mutant allele. Evidence: IEA. (OMIM:175750)